Phenotypes associated with the disease 46,XY disorder of sex development due to testicular 17,20-desmolase deficiency (OMIM:614279):
- Sex reversal (HP:0012245): Development of the reproductive system is inconsistent with the chromosomal sex. Evidence: TAS. (OMIM:614279)
- Ambiguous genitalia (HP:0000062): A genital phenotype that is not clearly assignable to a single gender. Ambiguous genitalia can be evaluated using the Prader scale: Prader 0: Normal female external genitalia. Prader 1: Female external genitalia with clitoromegaly. Prader 2: Clitoromegaly with partial labial fusion forming a funnel-shaped urogenital sinus. Prader 3: Increased phallic enlargement. Complete labioscrotal fusion forming a urogenital sinus with a single opening. Prader 4: Complete scrotal fusion with urogenital opening at the base or on the shaft of the phallus. Prader 5: Normal male external genitalia. The diagnosis of ambiguous genitalia is made for Prader 1-4. Evidence: TAS. (OMIM:614279)
- Autosomal recessive inheritance (HP:0000007): A mode of inheritance that is observed for traits related to a gene encoded on one of the autosomes (i.e., the human chromosomes 1-22) in which a trait manifests in individuals with two pathogenic alleles, either homozygotes (two copies of the same mutant allele) or compound heterozygotes (whereby each copy of a gene has a distinct mutant allele). Evidence: TAS. (OMIM:614279)
- Male pseudohermaphroditism (HP:0000037): Hermaphroditism refers to a discrepancy between the morphology of the gonads and that of the external genitalia. In male pseudohermaphroditism, the genotype is male (XY) and the external genitalia are imcompletely virilized, ambiguous, or complete female. If gonads are present, they are testes. Evidence: TAS. (OMIM:614279)
- Cryptorchidism (HP:0000028): Testis in inguinal canal. That is, absence of one or both testes from the scrotum owing to failure of the testis or testes to descend through the inguinal canal to the scrotum. Evidence: TAS. (OMIM:614279)